Phenotypes associated with the disease Dracunculiasis (ORPHA:231):
- Skin rash (HP:0000988): A red eruption of the skin. Evidence: TAS. Frequency: Very frequent (HP:0040281). (ORPHA:231)
- Pruritus (HP:0000989): Pruritus is an itch or a sensation that makes a person want to scratch. This term refers to an abnormally increased disposition to experience pruritus. Evidence: TAS. Frequency: Very frequent (HP:0040281). (ORPHA:231)
- Arthritis (HP:0001369): Inflammation of a joint. Evidence: TAS. Frequency: Frequent (HP:0040282). (ORPHA:231)
- Flexion contracture (HP:0001371): A flexion contracture is a bent (flexed) joint that cannot be straightened actively or passively. It is thus a chronic loss of joint motion due to structural changes in muscle, tendons, ligaments, or skin that prevents normal movement of joints. Evidence: TAS. Frequency: Occasional (HP:0040283). (ORPHA:231)
- Limitation of joint mobility (HP:0001376): A reduction in the freedom of movement of one or more joints. Evidence: TAS. Frequency: Frequent (HP:0040282). (ORPHA:231)
- Subcutaneous nodule (HP:0001482): Slightly elevated lesions on or in the skin with a diameter of over 5 mm. Evidence: TAS. Frequency: Very frequent (HP:0040281). (ORPHA:231)
- Diarrhea (HP:0002014): Abnormally increased frequency (usually defined as three or more) loose or watery bowel movements a day. Evidence: TAS. Frequency: Very frequent (HP:0040281). (ORPHA:231)
- Nausea and vomiting (HP:0002017): Nausea is a commonly encountered symptom that has been defined as an unpleasant painless subjective feeling that one will imminently vomit. Vomiting has been defined as the forceful expulsion of the contents of the stomach, duodenum, or jejunum through the oral cavity. While nausea and vomiting are often thought to exist on a temporal continuum, this is not always the case. There are situations when severe nausea may be present without emesis and less frequently, when emesis may be present without preceding nausea. Evidence: TAS. Frequency: Very frequent (HP:0040281). (ORPHA:231)
- Abnormal blistering of the skin (HP:0008066): The presence of one or more bullae on the skin, defined as fluid-filled blisters more than 5 mm in diameter with thin walls. Evidence: TAS. Frequency: Very frequent (HP:0040281). (ORPHA:231)
- Low-grade fever (HP:0011134): Mild fever that does not exceed 38.5 degrees centigrade. Evidence: TAS. Frequency: Very frequent (HP:0040281). (ORPHA:231)
- Immunologic hypersensitivity (HP:0100326): Immunological states where the immune system produces harmful responses upon reexposure to sensitizing antigens. Evidence: TAS. Frequency: Frequent (HP:0040282). (ORPHA:231)
- Cellulitis (HP:0100658): A bacterial infection and inflammation of the skin und subcutaneous tissues. Evidence: TAS. Frequency: Frequent (HP:0040282). (ORPHA:231)
- Gangrene (HP:0100758): A serious and potentially life-threatening condition that arises when a considerable mass of body tissue dies (necrosis). Evidence: TAS. Frequency: Occasional (HP:0040283). (ORPHA:231)
- Recurrent cutaneous abscess formation (HP:0100838): An increased susceptibility to cutaneous abscess formation, as manifested by a medical history of recurrent cutaneous abscesses. Evidence: TAS. Frequency: Frequent (HP:0040282). (ORPHA:231)
- Skin ulcer (HP:0200042): A discontinuity of the skin exhibiting complete loss of the epidermis and often portions of the dermis and even subcutaneous fat. Evidence: TAS. Frequency: Very frequent (HP:0040281). (ORPHA:231)